Phenotypes associated with the disease Botulism (ORPHA:1267):
- Urinary retention (HP:0000016): Inability to completely empty the urinary bladder during the process of urination. Evidence: TAS. Frequency: Frequent (HP:0040282). (ORPHA:1267)
- Xerostomia (HP:0000217): Dryness of the mouth due to salivary gland dysfunction. Evidence: TAS. Frequency: Very frequent (HP:0040281). (ORPHA:1267)
- Diplopia (HP:0000651): Diplopia is a condition in which a single object is perceived as two images, it is also known as double vision. Evidence: TAS. Frequency: Very frequent (HP:0040281). (ORPHA:1267)
- Dysarthria (HP:0001260): Dysarthric speech is a general description referring to a neurological speech disorder characterized by poor articulation. Depending on the involved neurological structures, dysarthria may be further classified as spastic, flaccid, ataxic, hyperkinetic and hypokinetic, or mixed. Evidence: TAS. Frequency: Very frequent (HP:0040281). (ORPHA:1267)
- Diarrhea (HP:0002014): Abnormally increased frequency (usually defined as three or more) loose or watery bowel movements a day. Evidence: TAS. Frequency: Occasional (HP:0040283). (ORPHA:1267)
- Dysphagia (HP:0002015): Difficulty in swallowing. Evidence: TAS. Frequency: Very frequent (HP:0040281). (ORPHA:1267)
- Nausea and vomiting (HP:0002017): Nausea is a commonly encountered symptom that has been defined as an unpleasant painless subjective feeling that one will imminently vomit. Vomiting has been defined as the forceful expulsion of the contents of the stomach, duodenum, or jejunum through the oral cavity. While nausea and vomiting are often thought to exist on a temporal continuum, this is not always the case. There are situations when severe nausea may be present without emesis and less frequently, when emesis may be present without preceding nausea. Evidence: TAS. Frequency: Frequent (HP:0040282). (ORPHA:1267)
- Constipation (HP:0002019): Infrequent or difficult evacuation of feces. Evidence: TAS. Frequency: Frequent (HP:0040282). (ORPHA:1267)
- Abdominal pain (HP:0002027): An unpleasant sensation characterized by physical discomfort (such as pricking, throbbing, or aching) and perceived to originate in the abdomen. Evidence: TAS. Frequency: Very frequent (HP:0040281). (ORPHA:1267)
- Respiratory insufficiency (HP:0002093). Evidence: TAS. Frequency: Frequent (HP:0040282). (ORPHA:1267)
- Diaphragmatic paralysis (HP:0006597): The presence of a paralyzed diaphragm. Evidence: TAS. Frequency: Very frequent (HP:0040281). (ORPHA:1267)
- Cranial nerve paralysis (HP:0006824). Evidence: TAS. Frequency: Very frequent (HP:0040281). (ORPHA:1267)
- Muscle flaccidity (HP:0010547): A type of paralysis in which a muscle becomes soft and yields to passive stretching, which results from loss of all or practically all peripheral motor nerves that innervated the muscle. Muscle tone is reduced and the affected muscles undergo extreme atrophy within months of the loss of innervation. Evidence: TAS. Frequency: Very frequent (HP:0040281). (ORPHA:1267)
- Mydriasis (HP:0011499): Abnormal dilatation of the iris. Evidence: TAS. Frequency: Very frequent (HP:0040281). (ORPHA:1267)
- Arrhythmia (HP:0011675): Any cardiac rhythm other than the normal sinus rhythm. Such a rhythm may be either of sinus or ectopic origin and either regular or irregular. An arrhythmia may be due to a disturbance in impulse formation or conduction or both. Evidence: TAS. Frequency: Frequent (HP:0040282). (ORPHA:1267)
- Cerebral palsy (HP:0100021): Cerebral palsy describes a group of permanent disorders of the development of movement and posture, causing activity limitation, that are attributed to nonprogressive disturbances that occurred in the developing fetal or infant brain. The motor disorders of cerebral palsy are often accompanied by disturbances of sensation, perception, cognition, communication, and behavior, by epilepsy, and by secondary musculoskeletal problems. Evidence: TAS. Frequency: Very frequent (HP:0040281). (ORPHA:1267)
- Diaphragmatic weakness (HP:0009113): A decrease in the strength of the diaphragm. Evidence: TAS. Frequency: Occasional (HP:0040283). (ORPHA:1267)
- Fatigue (HP:0012378): A subjective feeling of tiredness characterized by a lack of energy and motivation. Evidence: TAS. Frequency: Very frequent (HP:0040281). (ORPHA:1267)